- Elevated circulating aspartate aminotransferase concentration (HP:0031956): The concentration of aspartate aminotransferase (AST) in the blood circulation is above the upper limit of normal. Evidence: PCS. Frequency: 1/1. (PMID:12709789)
- Decreased activity of mitochondrial complex III (HP:0011924): A reduction in the activity of the mitochondrial respiratory chain complex III, which is part of the electron transport chain in mitochondria. Evidence: PCS. Frequency: 1/1. (PMID:12709789)
- Increased circulating lactate concentration (HP:0002151): Abnormally increased level of blood lactate (2-hydroxypropanoic acid). Lactate is produced from pyruvate by lactate dehydrogenase during normal metabolism. The terms lactate and lactic acid are often used interchangeably but lactate (the component measured in blood) is strictly a weak base whereas lactic acid is the corresponding acid. Lactic acidosis is often used clinically to describe elevated lactate but should be reserved for cases where there is a corresponding acidosis (pH below 7.35). Evidence: PCS. Frequency: 1/1. (PMID:12709789)
- Hepatomegaly (HP:0002240): Abnormally increased size of the liver. Evidence: PCS. Frequency: 1/1. (PMID:12709789)
- Infantile onset (HP:0003593): Onset of signs or symptoms of disease between 28 days to one year of life. Evidence: PCS. Frequency: 1/1. (PMID:12709789)
- Autosomal recessive inheritance (HP:0000007): A mode of inheritance that is observed for traits related to a gene encoded on one of the autosomes (i.e., the human chromosomes 1-22) in which a trait manifests in individuals with two pathogenic alleles, either homozygotes (two copies of the same mutant allele) or compound heterozygotes (whereby each copy of a gene has a distinct mutant allele). Evidence: PCS. (PMID:12709789)
- Hypoglycemia (HP:0001943): A decreased concentration of glucose in the blood. Evidence: PCS. Frequency: 1/1. (PMID:12709789)
- Alaninuria (HP:0020078): An increased level of alanine in the urine. Evidence: PCS. Frequency: 1/1. (PMID:12709789)
- Neurodevelopmental abnormality (HP:0012759): A deviation from normal of the neurological development of a child, which may include any or all of the aspects of the development of personal, social, gross or fine motor, and cognitive abilities. Evidence: PCS. Frequency: 0/1. (PMID:12709789)
- Metabolic acidosis (HP:0001942): Metabolic acidosis (MA) is characterized by a fall in blood pH due to a reduction of serum bicarbonate concentration. This can occur as a result of either the accumulation of acids (high anion gap MA) or the loss of bicarbonate from the gastrointestinal tract or the kidney (hyperchloremic MA). By definition, MA is not due to a respirary cause. Evidence: PCS. Frequency: 1/1. (PMID:12709789)
- Elevated circulating alanine aminotransferase concentration (HP:0031964): An abnormally high concentration in the circulation of alanine aminotransferase (ALT). Evidence: PCS. Frequency: 1/1. (PMID:12709789)
These phenotypes are associated with the disease mitochondrial complex III deficiency nuclear type 3 (OMIM:615158).